Phenotypes associated with the disease Benign hereditary chorea (ORPHA:1429):
- Gait disturbance (HP:0001288): The term gait disturbance can refer to any disruption of the ability to walk. Evidence: TAS. Frequency: Very frequent (HP:0040281). (ORPHA:1429)
- Abnormality of movement (HP:0100022): An abnormality of movement with a neurological basis characterized by changes in coordination and speed of voluntary movements. Evidence: TAS. Frequency: Very frequent (HP:0040281). (ORPHA:1429)